- Dyspnea (HP:0002094): Difficult or labored breathing. Dyspnea is a subjective feeling only the patient can rate, e.g., on a Borg scale. Evidence: TAS. Frequency: Very frequent (HP:0040281). (ORPHA:1303)
- Airway obstruction (HP:0006536): Obstruction of conducting airways of the lung. Evidence: TAS. Frequency: Very frequent (HP:0040281). (ORPHA:1303)
- Bronchiolitis obliterans (HP:0011946): Inflammation and fibrosis of the bronchioles leading to partial or complete obstruction of these airways. Evidence: TAS. Frequency: Very frequent (HP:0040281). (ORPHA:1303)
- Hypoxemia (HP:0012418): An abnormally low level of blood oxygen. Evidence: TAS. Frequency: Very frequent (HP:0040281). (ORPHA:1303)
- Cough (HP:0012735): A sudden, audible expulsion of air from the lungs through a partially closed glottis, preceded by inhalation. Evidence: TAS. Frequency: Very frequent (HP:0040281). (ORPHA:1303)
- Reduced FEV1/FVC ratio (HP:0030877): Abnormally low FEV1/FVC (FEV1 - forced expiratory volume in 1 second; FVC forced vital capacity). Evidence: TAS. Frequency: Very frequent (HP:0040281). (ORPHA:1303)
- Reduced forced vital capacity (HP:0032341): An abnormal reduction in the amount of air a person can expel following maximal inspiration. Evidence: TAS. Frequency: Very frequent (HP:0040281). (ORPHA:1303)
- Reduced forced expiratory volume in one second (HP:0032342): An abnormal reduction in the amount of air a person can forcefully expel in one second. Evidence: TAS. Frequency: Very frequent (HP:0040281). (ORPHA:1303)
- Decreased forced expiratory flow 25-75% (HP:0032359): A reduction compared to the predicted value of the forced expiratory flow over the middle one-half of the FVC; the average flow from the point at which 25% of the FVC has been exhaled to the point at which 75% of the FVC has been exhaled. Evidence: TAS. Frequency: Very frequent (HP:0040281). (ORPHA:1303)
- Pneumonia (HP:0002090): Inflammation of any part of the lung parenchyma. Evidence: TAS. Frequency: Frequent (HP:0040282). (ORPHA:1303)
- Respiratory tract infection (HP:0011947): An infection of the upper or lower respiratory tract. Evidence: TAS. Frequency: Frequent (HP:0040282). (ORPHA:1303)
- Nonproductive cough (HP:0031246): A cough that does not produce phlegm or mucus. Evidence: TAS. Frequency: Frequent (HP:0040282). (ORPHA:1303)
- Decreased DLCO (HP:0045051): Reduced ability of the lungs to transfer gas from inspired air to the bloodstream as measured by the diffusing capacity of the lungs for carbon monoxide (DLCO) test. Evidence: TAS. Frequency: Frequent (HP:0040282). (ORPHA:1303)
- Bronchiectasis (HP:0002110): Persistent abnormal dilatation of the bronchi owing to localized and irreversible destruction and widening of the large airways. Evidence: TAS. Frequency: Occasional (HP:0040283). (ORPHA:1303)
- Autoimmunity (HP:0002960): The occurrence of an immune reaction against the organism's own cells or tissues. Evidence: TAS. Frequency: Occasional (HP:0040283). (ORPHA:1303)
- Ground-glass opacification (HP:0025179): On chest radiographs, ground-glass opacity appears as an area of hazy increased lung opacity, usually extensive, within which margins of pulmonary vessels may be indistinct. On CT scans, it appears as hazy increased opacity of lung, with preservation of bronchial and vascular margins. It is caused by partial filling of airspaces, interstitial thickening (due to fluid, cells, and/or fibrosis), partial collapse of alveoli, increased capillary blood volume, or a combination of these, the common factor being the partial displacement of air. Ground-glass opacity is less opaque than consolidation, in which bronchovascular margins are obscured. Evidence: TAS. Frequency: Very rare (HP:0040284). (ORPHA:1303)
These phenotypes are associated with the disease Bronchiolitis obliterans (ORPHA:1303).